- Headache (HP:0002315): Cephalgia, or pain sensed in various parts of the head, not confined to the area of distribution of any nerve. Evidence: TAS. Frequency: Very frequent (HP:0040281). (ORPHA:238624)
- Increased intracranial pressure (HP:0002516): An increase of the pressure inside the cranium (skull) and thereby in the brain tissue and cerebrospinal fluid. Evidence: TAS. Frequency: Very frequent (HP:0040281). (ORPHA:238624)
- Papilledema (HP:0001085): Papilledema refers to edema (swelling) of the optic disc secondary to any factor which increases cerebral spinal fluid pressure. Evidence: TAS. Frequency: Frequent (HP:0040282). (ORPHA:238624)
- Obesity (HP:0001513): Accumulation of substantial excess body fat. Evidence: TAS. Frequency: Frequent (HP:0040282). (ORPHA:238624)
- Allergy (HP:0012393): An allergy is an immune response or reaction to substances that are usually not harmful. Evidence: TAS. Frequency: Frequent (HP:0040282). (ORPHA:238624)
- Visual loss (HP:0000572): Loss of visual acuity (implying that vision was better at a certain time point in life). Otherwise the term reduced visual acuity should be used (or a subclass of that). Evidence: TAS. Frequency: Occasional (HP:0040283). (ORPHA:238624)
- Photophobia (HP:0000613): Excessive sensitivity to light with the sensation of discomfort or pain in the eyes due to exposure to bright light. Evidence: TAS. Frequency: Occasional (HP:0040283). (ORPHA:238624)
- Blurred vision (HP:0000622): Lack of sharpness of vision resulting in the inability to see fine detail. Evidence: TAS. Frequency: Occasional (HP:0040283). (ORPHA:238624)
- Diplopia (HP:0000651): Diplopia is a condition in which a single object is perceived as two images, it is also known as double vision. Evidence: TAS. Frequency: Occasional (HP:0040283). (ORPHA:238624)
- Vomiting (HP:0002013): Forceful ejection of the contents of the stomach through the mouth by means of a series of involuntary spasmic contractions. Evidence: TAS. Frequency: Occasional (HP:0040283). (ORPHA:238624)
- Nausea (HP:0002018): A sensation of unease in the stomach together with an urge to vomit. Evidence: TAS. Frequency: Occasional (HP:0040283). (ORPHA:238624)
- Sleep disturbance (HP:0002360): An abnormal pattern in the quality, quantity, or characteristics of sleep. Evidence: TAS. Frequency: Occasional (HP:0040283). (ORPHA:238624)
- Scintillating scotoma (HP:0010822): A scintillating scotoma is a common visual aura that can precede a migraine, whereby a spot of flickering light near the center of the visual fields occurs. The spot prevents vision, and is thus termed scotoma. The scotoma can extend into one or more shimmering arcs of white or colored flashing lights. Evidence: TAS. Frequency: Occasional (HP:0040283). (ORPHA:238624)
- Abnormal emotional state (HP:0100851): A disturbance in the experience or expression of emotion, characterized by alterations in valence, intensity, frequency, or duration. It may also involve emotional responses that are mismatched, exaggerated, or incongruent relative to internal expectations or external contextual stimuli, such as experiencing negative affect in response to neutral or positive events. Evidence: TAS. Frequency: Occasional (HP:0040283). (ORPHA:238624)
- Depression (HP:0000716): Frequently experiencing feelings of being down, miserable, and/or hopeless; struggling to recover from these moods; having a pessimistic outlook on the future; feeling a pervasive sense of shame; having a low self-worth; experiencing thoughts of suicide and engaging in suicidal behavior. Evidence: TAS. Frequency: Very rare (HP:0040284). (ORPHA:238624)
- Lethargy (HP:0001254): A state of fatigue, either physical or mental slowness and sluggishness, with difficulties in initiating or performing simple tasks. Distinguished from apathy which implies indifference and a lack of desire or interest in the task. A person with lethargy may have the desire, but not the energy to engage in personal or socially relevant tasks. Evidence: TAS. Frequency: Very rare (HP:0040284). (ORPHA:238624)
- Migraine (HP:0002076): Migraine is a chronic neurological disorder characterized by episodic attacks of headache and associated symptoms. Evidence: TAS. Frequency: Very rare (HP:0040284). (ORPHA:238624)
- Vertigo (HP:0002321): An abnormal sensation of spinning while the body is actually stationary. Evidence: TAS. Frequency: Very rare (HP:0040284). (ORPHA:238624)
- Back pain (HP:0003418): An unpleasant sensation characterized by physical discomfort (such as pricking, throbbing, or aching) localized to the back. Evidence: TAS. Frequency: Very rare (HP:0040284). (ORPHA:238624)
- Pulsatile tinnitus (HP:0008629): Pulsatile tinnitus is generally classified a kind of objective tinnitus, meaning that it is not only audible to the patient but also to the examiner on auscultation of the auditory canal and/or of surrounding structures with use of an auscultation tube or stethoscope. Usually, pulsatile tinnitus is heard as a lower pitched thumping or booming, a rougher blowing sound which is coincidental with respiration, or as a clicking, higher pitched rhythmic sensation. Evidence: TAS. Frequency: Very rare (HP:0040284). (ORPHA:238624)
- Focal sensory seizure with olfactory features (HP:0011161): Seizures characterized by olfactory phenomena as its first clinical manifestation. Evidence: TAS. Frequency: Very rare (HP:0040284). (ORPHA:238624)
These phenotypes are associated with the disease Idiopathic intracranial hypertension (ORPHA:238624).